- Narrow forehead (HP:0000341): Width of the forehead or distance between the frontotemporales is more than two standard deviations below the mean (objective); or apparently narrow intertemporal region (subjective). Evidence: PCS. Frequency: 2/3. (PMID:35202563)
- 3-4 finger cutaneous syndactyly (HP:0011939): A soft tissue continuity in the A/P axis between fingers 3 and 4. Evidence: PCS. Frequency: 1/3. (PMID:35202563)
- Preauricular pit (HP:0004467): Small indentation anterior to the insertion of the ear. Evidence: PCS. Frequency: 3/3. (PMID:35202563)
- Preauricular skin tag (HP:0000384): A rudimentary tag of skin often containing ear tissue including a core of cartilage and located just anterior to the auricle (outer part of the ear). Evidence: PCS. Frequency: 1/3. (PMID:35202563)
- Strabismus (HP:0000486): A misalignment of the eyes so that the visual axes deviate from bifoveal fixation. The classification of strabismus may be based on a number of features including the relative position of the eyes, whether the deviation is latent or manifest, intermittent or constant, concomitant or otherwise and according to the age of onset and the relevance of any associated refractive error. Evidence: PCS. Frequency: 3/6. (PMID:35202563)
- Everted upper lip vermilion (HP:0010803): Inner aspect of the upper lip vermilion (normally apposing the teeth) visible in a frontal view, i.e., the presence of an everted upper lip. Evidence: PCS. Frequency: 1/3. (PMID:35202563)
- Hearing impairment (HP:0000365): A decreased magnitude of the sensory perception of sound. Evidence: PCS. Frequency: 2/3. (PMID:35202563)
- Deep philtrum (HP:0002002): Accentuated, prominent philtral ridges giving rise to an exaggerated groove in the midline between the nasal base and upper vermillion border. Evidence: PCS. Frequency: 1/3. (PMID:35202563)
- Unilateral renal agenesis (HP:0000122): A unilateral form of agenesis of the kidney. Evidence: PCS. Frequency: 1/3. (PMID:35202563)
- Camptodactyly of finger (HP:0100490): The distal interphalangeal joint and/or the proximal interphalangeal joint of the fingers cannot be extended to 180 degrees by either active or passive extension. Evidence: PCS. Frequency: 1/3. (PMID:35202563)
- Hypotonia (HP:0001252): Hypotonia is an abnormally low muscle tone (the amount of tension or resistance to movement in a muscle). Even when relaxed, muscles have a continuous and passive partial contraction which provides some resistance to passive stretching. Hypotonia thus manifests as diminished resistance to passive stretching. Hypotonia is not the same as muscle weakness, although the two conditions can co-exist. Evidence: PCS. Frequency: 1/3. (PMID:35202563)
- Infantile onset (HP:0003593): Onset of signs or symptoms of disease between 28 days to one year of life. Evidence: PCS. Frequency: 3/3. (PMID:35202563)
- Bicoronal synostosis (HP:0011318): Synostosis affecting the right and the left coronal suture. Evidence: PCS. Frequency: 1/3. (PMID:35202563)
- Leukemia (HP:0001909): A cancer of the blood and bone marrow characterized by an abnormal proliferation of leukocytes. Evidence: PCS. Frequency: 1/3. (PMID:35202563)
- Hypertelorism (HP:0000316): Interpupillary distance more than 2 SD above the mean (alternatively, the appearance of an increased interpupillary distance or widely spaced eyes). Evidence: PCS. Frequency: 2/3. (PMID:35202563)
- Single transverse palmar crease (HP:0000954): The distal and proximal transverse palmar creases are merged into a single transverse palmar crease. Evidence: PCS. Frequency: 1/3. (PMID:35202563)
- Hydrocephalus (HP:0000238): Hydrocephalus is an active distension of the ventricular system of the brain resulting from inadequate passage of CSF from its point of production within the cerebral ventricles to its point of absorption into the systemic circulation. Evidence: PCS. Frequency: 1/2. (PMID:35202563)
- Hallux valgus (HP:0001822): Lateral deviation of the great toe (i.e., in the direction of the little toe). Evidence: PCS. Frequency: 1/3. (PMID:35202563)
- Reduced visual acuity (HP:0007663). Evidence: PCS. Frequency: 1/3. (PMID:35202563)
- Supernumerary nipple (HP:0002558): Presence of more than two nipples. Evidence: PCS. Frequency: 1/3. (PMID:35202563)
- Intellectual disability (HP:0001249): The term intellectual disability or intellectual developmental disorder is used to describe significantly sub-average intellectual and adaptive functioning based on clinical assessment and as measured by individually administered, appropriately normed, standardized and validated tests of intellectual functioning and adaptive behavior, with onset during the developmental period from infancy through adolescence. Evidence: PCS. Frequency: 1/2. (PMID:35202563)
- Posteriorly rotated ears (HP:0000358): A type of abnormal location of the ears in which the position of the ears is characterized by posterior rotation (the superior part of the ears is rotated towards the back of the head, and the inferior part of the ears towards the front). Evidence: PCS. Frequency: 1/3. (PMID:35202563)
- Highly arched eyebrow (HP:0002553): Increased height of the central portion of the eyebrow, forming a crescent, semicircular, or inverted U shape. Evidence: PCS. Frequency: 1/3. (PMID:35202563)
- Downslanted palpebral fissures (HP:0000494): The palpebral fissure inclination is more than two standard deviations below the mean. Evidence: PCS. Frequency: 1/3. (PMID:35202563)
- Micropenis (HP:0000054): Abnormally small penis. At birth, the normal penis is about 3 cm (stretched length from pubic tubercle to tip of penis) with micropenis less than 2.0-2.5 cm. Evidence: PCS. Frequency: 1/1. (PMID:35202563)
- Vesicoureteral reflux (HP:0000076): Abnormal (retrograde) movement of urine from the bladder into ureters or kidneys related to inadequacy of the valvular mechanism at the ureterovesicular junction or other causes. Evidence: PCS. Frequency: 1/3. (PMID:35202563)
- Scoliosis (HP:0002650): The presence of an abnormal lateral curvature of the spine. Evidence: PCS. Frequency: 1/3. (PMID:35202563)
- Secundum atrial septal defect (HP:0001684): A kind of atrial septum defect arising from an enlarged foramen ovale, inadequate growth of the septum secundum, or excessive absorption of the septum primum. Evidence: PCS. Frequency: 1/3. (PMID:35202563)
- Feeding difficulties (HP:0011968): Impaired ability to eat related to problems gathering food and getting ready to suck, chew, or swallow it. Evidence: PCS. Frequency: 1/3. (PMID:35202563)
- Joint hypermobility (HP:0001382): The capability that a joint (or a group of joints) has to move, passively and/or actively, beyond normal limits along physiological axes. Evidence: PCS. Frequency: 1/3. (PMID:35202563)
- Global developmental delay (HP:0001263): A delay in the achievement of motor or mental milestones in the domains of development of a child, including motor skills, speech and language, cognitive skills, and social and emotional skills. This term should only be used to describe children younger than five years of age. Evidence: PCS. Frequency: 3/3. (PMID:35202563)
- 2-3 toe syndactyly (HP:0004691): Syndactyly with fusion of toes two and three. Evidence: PCS. Frequency: 1/3. (PMID:35202563)
- Depressed nasal bridge (HP:0005280): Posterior positioning of the nasal root in relation to the overall facial profile for age. Evidence: PCS. Frequency: 1/3. (PMID:35202563)
- Dilation of Virchow-Robin spaces (HP:0012520): Increased dimensions of the Virchow-Robin spaces (also known as perivascular spaces), which surround the walls of vessels as they course from the subarachnoid space through the brain parenchyma. Perivascular spaces are commonly microscopic, and not visible on conventional neuroimaging. This term refers to an increase of size of these spaces such that they are visible on neuroimaging (usually magnetic resonance imaging). The dilatations are regular cavities that always contain a patent artery. Evidence: PCS. Frequency: 1/2. (PMID:35202563)
- Rocker bottom foot (HP:0001838): The presence of both a prominent heel and a convex contour of the sole. Evidence: PCS. Frequency: 1/3. (PMID:35202563)
- Kyphosis (HP:0002808): Exaggerated anterior convexity of the thoracic vertebral column. Evidence: PCS. Frequency: 1/3. (PMID:35202563)
- Prominent nasal bridge (HP:0000426): Anterior positioning of the nasal root in comparison to the usual positioning for age. Evidence: PCS. Frequency: 1/3. (PMID:35202563)
- Sandal gap (HP:0001852): A widely spaced gap between the first toe (the great toe) and the second toe. Evidence: PCS. Frequency: 1/3. (PMID:35202563)
- Short philtrum (HP:0000322): Distance between nasal base and midline upper lip vermilion border more than 2 SD below the mean. Alternatively, an apparently decreased distance between nasal base and midline upper lip vermilion border. Evidence: PCS. Frequency: 2/3. (PMID:35202563)
- Autosomal dominant inheritance (HP:0000006): A mode of inheritance that is observed for traits related to a gene encoded on one of the autosomes (i.e., the human chromosomes 1-22) in which a trait manifests in heterozygotes. In the context of medical genetics, an autosomal dominant disorder is caused when a single copy of the mutant allele is present. Males and females are affected equally, and can both transmit the disorder with a risk of 50% for each child of inheriting the mutant allele. Evidence: PCS. (PMID:35202563)
- Micrognathia (HP:0000347): Developmental hypoplasia of the mandible. Evidence: PCS. Frequency: 1/3. (PMID:35202563)
- Low-set ears (HP:0000369): Upper insertion of the ear to the scalp below an imaginary horizontal line drawn between the inner canthi of the eye and extending posteriorly to the ear. Evidence: PCS. Frequency: 1/3. (PMID:35202563)
- Cryptorchidism (HP:0000028): Testis in inguinal canal. That is, absence of one or both testes from the scrotum owing to failure of the testis or testes to descend through the inguinal canal to the scrotum. Evidence: PCS. Frequency: 1/1. (PMID:35202563)
- Myelodysplasia (HP:0002863): Clonal hematopoietic stem cell disorders characterized by dysplasia (ineffective production) in one or more hematopoietic cell lineages, leading to anemia and cytopenia. Evidence: PCS. Frequency: 1/3. (PMID:35202563)
These phenotypes are associated with the disease Tessadori-Van Haaften neurodevelopmental syndrome 4 (OMIM:619951).